Phenotypes associated with the disease epilepsy, idiopathic generalized, susceptibility to, 18 (OMIM:619521):
- Delayed speech and language development (HP:0000750): A degree of language development that is significantly below the norm for a child of a specified age. Evidence: PCS. Frequency: 2/2. (PMID:30127718)
- Mild intellectual disability (HP:0001256): Mild intellectual disability (ID) is defined as a type of ID characterized by mildly sub-average adaptive functioning and intellectual functioning, with an intelligence quotient (IQ) the range of 50-69. Evidence: PCS. Frequency: 1/2. (PMID:30127718)
- Bradycardia (HP:0001662): A slower than normal heart rate (in adults, slower than 60 beats per minute). Evidence: PCS. Frequency: 2/2. (PMID:30127718)
- Infantile onset (HP:0003593): Onset of signs or symptoms of disease between 28 days to one year of life. Evidence: IEA. Frequency: 2/2. (PMID:30127718)
- Myoclonic seizure (HP:0032794): A myoclonic seizure is a type of motor seizure characterized by sudden, brief (<100 ms) involuntary single or multiple contraction of muscles or muscle groups of variable topography (axial, proximal limb, distal). Myoclonus is less regularly repetitive and less sustained than is clonus. Evidence: PCS. Frequency: 2/2. Onset: Infantile onset (HP:0003593). (PMID:30127718)
- Autosomal dominant inheritance (HP:0000006): A mode of inheritance that is observed for traits related to a gene encoded on one of the autosomes (i.e., the human chromosomes 1-22) in which a trait manifests in heterozygotes. In the context of medical genetics, an autosomal dominant disorder is caused when a single copy of the mutant allele is present. Males and females are affected equally, and can both transmit the disorder with a risk of 50% for each child of inheriting the mutant allele. Evidence: PCS. (PMID:30127718)